- Juvenile onset (HP:0003621): Onset of signs or symptoms of disease between the age of 5 and 15 years. Evidence: PCS. Frequency: 18/31. (PMID:11850618)
- Congenital onset (HP:0003577): A phenotypic abnormality that is present at birth. Evidence: PCS. Frequency: 13/31. (PMID:11850618)
- Abnormal vestibular function (HP:0001751): An abnormality of the functioning of the vestibular apparatus. Evidence: PCS. Frequency: 0/31. (PMID:11850618)
- Sensorineural hearing impairment (HP:0000407): A type of hearing impairment in one or both ears related to an abnormal functionality of the cochlear nerve. Evidence: PCS. (PMID:11850618)
- Autosomal recessive inheritance (HP:0000007): A mode of inheritance that is observed for traits related to a gene encoded on one of the autosomes (i.e., the human chromosomes 1-22) in which a trait manifests in individuals with two pathogenic alleles, either homozygotes (two copies of the same mutant allele) or compound heterozygotes (whereby each copy of a gene has a distinct mutant allele). Evidence: PCS. (PMID:11850618)
These phenotypes are associated with the disease autosomal recessive nonsyndromic hearing loss 7 (OMIM:600974).